- Autosomal dominant inheritance (HP:0000006): A mode of inheritance that is observed for traits related to a gene encoded on one of the autosomes (i.e., the human chromosomes 1-22) in which a trait manifests in heterozygotes. In the context of medical genetics, an autosomal dominant disorder is caused when a single copy of the mutant allele is present. Males and females are affected equally, and can both transmit the disorder with a risk of 50% for each child of inheriting the mutant allele. Evidence: IEA. (OMIM:102350)
- Abnormality of the skin (HP:0000951): An abnormality of the skin. Evidence: IEA. (OMIM:102350)
These phenotypes are associated with the disease acromial dimples (OMIM:102350).